- Subcutaneous nodule (HP:0001482): Slightly elevated lesions on or in the skin with a diameter of over 5 mm. Evidence: TAS. Frequency: Very frequent (HP:0040281). (ORPHA:867)
- Basal cell carcinoma (HP:0002671): The presence of a basal cell carcinoma of the skin. Evidence: TAS. Frequency: Occasional (HP:0040283). (ORPHA:867)
- Telangiectasia of the skin (HP:0100585): Presence of small, permanently dilated blood vessels near the surface of the skin, visible as small focal red lesions. Evidence: TAS. Frequency: Frequent (HP:0040282). (ORPHA:867)
- Papule (HP:0200034): A circumscribed, solid elevation of skin with no visible fluid, varying in size from a pinhead to less than 10mm in diameter at the widest point. Evidence: TAS. Frequency: Very frequent (HP:0040281). (ORPHA:867)
These phenotypes are associated with the disease Familial multiple trichoepithelioma (ORPHA:867).